- Glomerulopathy (HP:0100820): Inflammatory or noninflammatory diseases affecting the glomeruli of the nephron. Evidence: PCS. (PMID:18077821)
- Mesangial hypercellularity (HP:0012574): Increased numbers of mesangial cells per glomerulus, defined as more than 3 nuclei fully surrounded by matrix in one or more mesangial areas, not including perihilar region, on a standard 3-micron-thick tissue section, best evaluated on periodic acid-Schiff (PAS) stain. Evidence: PCS. (PMID:10432380)
- Renal insufficiency (HP:0000083): A reduction in the level of performance of the kidneys in areas of function comprising the concentration of urine, removal of wastes, the maintenance of electrolyte balance, homeostasis of blood pressure, and calcium metabolism. Evidence: PCS. (PMID:18077821)
- Proteinuria (HP:0000093): Increased levels of protein in the urine. Evidence: PCS. (PMID:18077821)
These phenotypes are associated with the disease lipoprotein glomerulopathy (OMIM:611771).